Phenotypes associated with the disease Neuhauser-Eichner-Opitz syndrome (ORPHA:2672):
- Ataxia (HP:0001251): Ataxia refers to impaired coordination of voluntary muscle movement. Cerebellar ataxia refers to ataxia due to dysfunction of the cerebellum. This causes a variety of elementary neurological deficits including asynergy (lack of coordination between muscles, limbs and joints), dysmetria (lack of ability to judge distances that can lead to under- or overshoot in grasping movements), and dysdiadochokinesia (inability to perform rapid movements requiring antagonizing muscle groups to be switched on and off repeatedly). Evidence: TAS. Frequency: Very frequent (HP:0040281). (ORPHA:2672)
- Spasticity (HP:0001257): A motor disorder characterized by a velocity-dependent increase in tonic stretch reflexes with increased muscle tone, exaggerated (hyperexcitable) tendon reflexes. Evidence: TAS. Frequency: Very frequent (HP:0040281). (ORPHA:2672)
- Hypertonia (HP:0001276): A condition in which there is increased muscle tone so that arms or legs, for example, are stiff and difficult to move. Evidence: TAS. Frequency: Very frequent (HP:0040281). (ORPHA:2672)
- Rigidity (HP:0002063): Continuous involuntary sustained muscle contraction. When an affected muscle is passively stretched, the degree of resistance remains constant regardless of the rate at which the muscle is stretched. This feature helps to distinguish rigidity from muscle spasticity. Evidence: TAS. Frequency: Very frequent (HP:0040281). (ORPHA:2672)
- Muscle stiffness (HP:0003552): A condition in which muscles cannot be moved quickly without accompanying pain or spasm. Evidence: TAS. Frequency: Very frequent (HP:0040281). (ORPHA:2672)
- Hyporeflexia (HP:0001265): Reduction of neurologic reflexes such as the knee-jerk reaction. Evidence: TAS. Frequency: Frequent (HP:0040282). (ORPHA:2672)
- Areflexia (HP:0001284): Absence of neurologic reflexes such as the knee-jerk reaction. Evidence: TAS. Frequency: Frequent (HP:0040282). (ORPHA:2672)
- Abnormality of movement (HP:0100022): An abnormality of movement with a neurological basis characterized by changes in coordination and speed of voluntary movements. Evidence: TAS. Frequency: Frequent (HP:0040282). (ORPHA:2672)
- Atypical behavior (HP:0000708): Atypical behavior is an abnormality in a person's actions that can be controlled or modulated by the will of the individual. While abnormal behaviors can be difficult to control, they are distinct from other abnormal actions that cannot be affected by the individual's will. Evidence: TAS. Frequency: Occasional (HP:0040283). (ORPHA:2672)
- Hypotonia (HP:0001252): Hypotonia is an abnormally low muscle tone (the amount of tension or resistance to movement in a muscle). Even when relaxed, muscles have a continuous and passive partial contraction which provides some resistance to passive stretching. Hypotonia thus manifests as diminished resistance to passive stretching. Hypotonia is not the same as muscle weakness, although the two conditions can co-exist. Evidence: TAS. Frequency: Occasional (HP:0040283). (ORPHA:2672)
- Mutism (HP:0002300): Complete lack of speech or verbal communication in a person despite attempts to engage in conversation. Mutism as a phenomena assumes the individual has previous capacity for speech and in the pediatric population it assumes that the person is past the age of typical language development. Evidence: TAS. Frequency: Occasional (HP:0040283). (ORPHA:2672)
- Aphasia (HP:0002381): An acquired language impairment of some or all of the abilities to produce or comprehend speech and to read or write. Evidence: TAS. Frequency: Occasional (HP:0040283). (ORPHA:2672)
- Echolalia (HP:0010529): Echolalia is the automatic imitative repetition of sounds, words, or phrases in the absence of explicit awareness. The repeated words or phrases are typically odd or used in a non-social manner. These can be words or phrases that the affected individual has heard or invented. Evidence: TAS. Frequency: Occasional (HP:0040283). (ORPHA:2672)
- Joint hypermobility (HP:0001382): The capability that a joint (or a group of joints) has to move, passively and/or actively, beyond normal limits along physiological axes. Evidence: TAS. Frequency: Frequent (HP:0040282). (ORPHA:2672)